- Serous retinal detachment (HP:0012231): A type of retinal detachment such that fluid is present in the subretinal space and separate the neurosensory retina from the retinal pigment epithelium. It is not associated with a full-thickness break nor a tractional component. Due to breakdown of outer blood-retina barrier or increased exudation from abnormal vasculature or defective outflow. Evidence: TAS. (OMIM:614224)
- Retinal arteriolar macroaneurysms (HP:0025355): Acquired focal dilatations of branches of the retinal artery, usually second-order retinal arterioles, that range in size from 100 to 200 micrometers in diameter. Macroaneurysms are generally located at the temporal retina and may be hemorrhagic or exudative. Evidence: PCS. Frequency: 22/22. (PMID:21835307)
- Autosomal recessive inheritance (HP:0000007): A mode of inheritance that is observed for traits related to a gene encoded on one of the autosomes (i.e., the human chromosomes 1-22) in which a trait manifests in individuals with two pathogenic alleles, either homozygotes (two copies of the same mutant allele) or compound heterozygotes (whereby each copy of a gene has a distinct mutant allele). Evidence: PCS. (PMID:21835307)
- Pulmonic stenosis (HP:0001642): A narrowing of the right ventricular outflow tract that can occur at the pulmonary valve (valvular stenosis), below the pulmonary valve (infundibular stenosis), or above the pulmonary valve (supravalvar stenosis). Evidence: PCS. Frequency: 13/13. (PMID:21835307)
These phenotypes are associated with the disease familial retinal arterial macroaneurysm (OMIM:614224).